Phenotypes associated with the disease sick sinus syndrome 4 (OMIM:619464):
- Childhood onset (HP:0011463): Onset of disease at the age of between 1 and 5 years. Evidence: PCS. (PMID:28219978)
- Abnormal PR interval (HP:0031593): An anomaly of the PR interval, which is the portion of the ECG from the onset of the P wave to the beginning of the QRS complex. A normal PR interval in adults is 0.12-0.2 seconds. Evidence: PCS. Frequency: 0/11. (PMID:28219978)
- Chronotropic incompetence (HP:0033992): Inability of the heart to increase its rate commensurate with increased activity or demand. Evidence: PCS. Frequency: 2/11. (PMID:28219978)
- Sinoatrial block (HP:0012723): Disturbance in the atrial activation that is caused by transient failure of impulse conduction from the sinoatrial node to the cardiac atria. Evidence: PCS. Frequency: 1/11. (PMID:28219978)
- Abnormal QRS complex (HP:0025074): An anomaly of the complex formed by the Q, R, and S waves, which occur in rapid succession on the electrocardiogram. Evidence: PCS. Frequency: 0/11. (PMID:28219978)
- Syncope (HP:0001279): A transient loss of consciousness (i.e., characterized by a rapid onset, a short duration, and a spontaneous and complete recovery) due to cerebral hypoperfusion. Evidence: PCS. Frequency: 3/11. Onset: Young adult onset (HP:0011462). (PMID:28219978)
- Paroxysmal atrial fibrillation (HP:0004757): Episodes of atrial fibrillation that typically last for several hours up to one day and terminate spontaneously. Evidence: PCS. Frequency: 3/11. (PMID:28219978)
- Autosomal dominant inheritance (HP:0000006): A mode of inheritance that is observed for traits related to a gene encoded on one of the autosomes (i.e., the human chromosomes 1-22) in which a trait manifests in heterozygotes. In the context of medical genetics, an autosomal dominant disorder is caused when a single copy of the mutant allele is present. Males and females are affected equally, and can both transmit the disorder with a risk of 50% for each child of inheriting the mutant allele. Evidence: PCS. (PMID:28219978)
- Atrioventricular block (HP:0001678): Delayed or lack of conduction of atrial depolarizations through the atrioventricular node to the ventricles. Evidence: PCS. Frequency: 9/11. (PMID:28219978)
- Sudden cardiac death (HP:0001645): The heart suddenly and unexpectedly stops beating resulting in death within a short time period (generally within 1 h of symptom onset). Evidence: PCS. Frequency: 0/11. (PMID:28219978)
- Sinus bradycardia (HP:0001688): Bradycardia related to a mean resting sinus rate of less than 50 beats per minute. Evidence: PCS. Frequency: 5/11. (PMID:28219978)
- Abnormal QT interval (HP:0031547): Any anomaly of the time interval between the start of the Q wave and the end of the T wave as measured by the electrocardiogram (EKG). Evidence: PCS. Frequency: 0/11. (PMID:28219978)